Phenotypes associated with the disease spermatogenic failure 37 (OMIM:618429):
- Irregularly shaped sperm tail (HP:0033393): Irregular or changing caliber (diameter) along the tail of the sperm. Evidence: PCS. Frequency: 3/3. (PMID:30929735)
- Coiled sperm flagella (HP:0032560): Sperm cells whose flagella are twisted (coiled). Evidence: PCS. Frequency: 3/3. (PMID:30929735)
- Male infertility (HP:0003251). Evidence: PCS. Frequency: 3/3. (PMID:30929735)
- Young adult onset (HP:0011462): Onset of disease at the age of between 16 and 40 years. Evidence: PCS. Frequency: 3/3. (PMID:30929735)
- Autosomal recessive inheritance (HP:0000007): A mode of inheritance that is observed for traits related to a gene encoded on one of the autosomes (i.e., the human chromosomes 1-22) in which a trait manifests in individuals with two pathogenic alleles, either homozygotes (two copies of the same mutant allele) or compound heterozygotes (whereby each copy of a gene has a distinct mutant allele). Evidence: PCS. (PMID:30929735)
- Reduced sperm motility (HP:0012207): An abnormal reduction in the mobility of ejaculated sperm. Evidence: PCS. Frequency: 3/3. (PMID:30929735)
- Absent sperm flagella (HP:0032558): Sperm cells lacking flagella. Evidence: PCS. Frequency: 3/3. (PMID:30929735)
- Short sperm flagella (HP:0032559): Sperm cells with abnormally short flagella. Evidence: PCS. Frequency: 3/3. (PMID:30929735)